Phenotypes associated with the disease glaucoma 1, open angle, O (OMIM:613100):
- Open angle glaucoma (HP:0012108): A type of glaucoma defined by an open, normal appearing anterior chamber angle and raised intraocular pressure,. Evidence: TAS. (OMIM:613100)